- Skin rash (HP:0000988): A red eruption of the skin. Evidence: TAS. Frequency: Very frequent (HP:0040281). (ORPHA:448237)
- Maculopapular exanthema (HP:0040186): A skin rash that is characterized by diffuse cutaneous erythema with areas of skin elevation. It may evolve to vesicles or papules as part of a more severe clinical entity. Different degrees of angioedema with involvement of subcutaneous tissue may also appear. Evidence: TAS. Frequency: Very frequent (HP:0040281). (ORPHA:448237)
- Conjunctivitis (HP:0000509): Inflammation of the conjunctiva. Evidence: TAS. Frequency: Frequent (HP:0040282). (ORPHA:448237)
- Pruritus (HP:0000989): Pruritus is an itch or a sensation that makes a person want to scratch. This term refers to an abnormally increased disposition to experience pruritus. Evidence: TAS. Frequency: Frequent (HP:0040282). (ORPHA:448237)
- Arthritis (HP:0001369): Inflammation of a joint. Evidence: TAS. Frequency: Frequent (HP:0040282). (ORPHA:448237)
- Fever (HP:0001945): Body temperature elevated above the normal range. Evidence: TAS. Frequency: Frequent (HP:0040282). (ORPHA:448237)
- Headache (HP:0002315): Cephalgia, or pain sensed in various parts of the head, not confined to the area of distribution of any nerve. Evidence: TAS. Frequency: Frequent (HP:0040282). (ORPHA:448237)
- Arthralgia (HP:0002829): Joint pain. Evidence: TAS. Frequency: Frequent (HP:0040282). (ORPHA:448237)
- Abnormal cerebrospinal fluid morphology (HP:0002921): An abnormality of the cerebrospinal fluid (CSF). Evidence: TAS. Frequency: Frequent (HP:0040282). (ORPHA:448237)
- Myalgia (HP:0003326): Pain in muscle. Evidence: TAS. Frequency: Frequent (HP:0040282). (ORPHA:448237)
- Increased circulating IgM concentration (HP:0003496): An abnormally increased level of immunoglobulin M in blood. Evidence: TAS. Frequency: Frequent (HP:0040282). (ORPHA:448237)
- Edema (HP:0000969): An abnormal accumulation of fluid beneath the skin, or in one or more cavities of the body. Evidence: TAS. Frequency: Occasional (HP:0040283). (ORPHA:448237)
- Wrist swelling (HP:0001225). Evidence: TAS. Frequency: Occasional (HP:0040283). (ORPHA:448237)
- Ankle swelling (HP:0001785). Evidence: TAS. Frequency: Occasional (HP:0040283). (ORPHA:448237)
- Vomiting (HP:0002013): Forceful ejection of the contents of the stomach through the mouth by means of a series of involuntary spasmic contractions. Evidence: TAS. Frequency: Occasional (HP:0040283). (ORPHA:448237)
- Transient hearing impairment (HP:0012779): Hearing loss that occurs acutely and resolves completely. Evidence: TAS. Frequency: Occasional (HP:0040283). (ORPHA:448237)
- Microcephaly (HP:0000252): Head circumference below 2 standard deviations below the mean for age and gender. Evidence: TAS. Frequency: Very rare (HP:0040284). (ORPHA:448237)
- Chorioretinal atrophy (HP:0000533): Atrophy (wasting) of the choroid and retinal layers of the fundus. Evidence: TAS. Frequency: Very rare (HP:0040284). (ORPHA:448237)
- Iris coloboma (HP:0000612): A coloboma of the iris. Evidence: TAS. Frequency: Very rare (HP:0040284). (ORPHA:448237)
- Lens subluxation (HP:0001132): Partial dislocation of the lens of the eye. Evidence: TAS. Frequency: Very rare (HP:0040284). (ORPHA:448237)
- Meningitis (HP:0001287): Inflammation of the meninges. Evidence: TAS. Frequency: Very rare (HP:0040284). (ORPHA:448237)
- Intrauterine growth retardation (HP:0001511): An abnormal restriction of fetal growth with fetal weight below the tenth percentile for gestational age. Evidence: TAS. Frequency: Very rare (HP:0040284). (ORPHA:448237)
- Thrombocytopenia (HP:0001873): A reduction in the number of circulating thrombocytes. Evidence: TAS. Frequency: Very rare (HP:0040284). (ORPHA:448237)
- Subcutaneous hemorrhage (HP:0001933): This term refers to an abnormally increased susceptibility to bruising (purpura, petechiae, or ecchymoses). Evidence: TAS. Frequency: Very rare (HP:0040284). (ORPHA:448237)
- Infectious encephalitis (HP:0002383): A disorder of the brain caused by an infectious agent that presents with fever, headache, and an altered level of consciousness. There may also be focal or multifocal neurologic deficits, and focal or generalized seizure activity. Evidence: TAS. Frequency: Very rare (HP:0040284). (ORPHA:448237)
- Miscarriage (HP:0005268): A pregnancy that ends at a stage in which the fetus is incapable of surviving on its own, defined as the spontaneous loss of a fetus before the 22th week of pregnancy. Evidence: TAS. Frequency: Very rare (HP:0040284). (ORPHA:448237)
- Congenital intracerebral calcification (HP:0006906): The presence of calcium deposition within brain structures that is present already at the time of birth. Evidence: TAS. Frequency: Very rare (HP:0040284). (ORPHA:448237)
- Acute demyelinating polyneuropathy (HP:0007131): Acute progressive areflexic weakness and mild sensory changes resulting from myelin breakdown and axonal degeneration. Evidence: TAS. Frequency: Very rare (HP:0040284). (ORPHA:448237)
- Macular atrophy (HP:0007401): A nonspecific term denoting wasting, especially as a result of degeneration, of the retinal pigment epithelium (RPE) and neurosensory retinal cells in the macula. Evidence: TAS. Frequency: Very rare (HP:0040284). (ORPHA:448237)
- Optic disc hypoplasia (HP:0007766): Underdevelopment of the optic disc, that is of the optic nerve head, where ganglion cell axons exit the eye to form the optic nerve. Evidence: TAS. Frequency: Very rare (HP:0040284). (ORPHA:448237)
- Retinal pigment epithelial mottling (HP:0007814): Mottling (spots or blotches of different shades) of the retinal pigment epithelium, i.e., localized or generalized fundus pigment granularity associated with processes at the level of the retinal pigment epithelium. Evidence: TAS. Frequency: Very rare (HP:0040284). (ORPHA:448237)
- Myelitis (HP:0012486): Inflammation of the spinal cord. Evidence: TAS. Frequency: Very rare (HP:0040284). (ORPHA:448237)
- Abnormal optic disc morphology (HP:0012795): A morphological abnormality of the optic disc, i.e., of the portion of the optic nerve clinically visible on fundoscopic examination. Evidence: TAS. Frequency: Very rare (HP:0040284). (ORPHA:448237)
- Absent foveal reflex (HP:0030825): Absent reflectivity of the fovea, which normally is a bright pinpoint of light that is observed to move sideways or up and down in response to movement of the opthalmoscope. Evidence: TAS. Frequency: Very rare (HP:0040284). (ORPHA:448237)
These phenotypes are associated with the disease Zika virus disease (ORPHA:448237).